- Hypoxemia (HP:0012418): An abnormally low level of blood oxygen. Evidence: TAS. Frequency: Frequent (HP:0040282). (ORPHA:36238)
- Nonproductive cough (HP:0031246): A cough that does not produce phlegm or mucus. Evidence: TAS. Frequency: Frequent (HP:0040282). (ORPHA:36238)
- Bacteremia (HP:0031864): Presence of viable bacteria in the blood. Evidence: TAS. Frequency: Frequent (HP:0040282). (ORPHA:36238)
- Parenchymal consolidation (HP:0032177): Consolidation refers to an exudate or other product of disease that replaces alveolar air, rendering the lung solid (as in infective pneumonia). Evidence: TAS. Frequency: Frequent (HP:0040282). (ORPHA:36238)
- Increased circulating procalcitonin concentration (HP:0032308): An elevated concentration of procalcitonin in the blood circulation. Evidence: TAS. Frequency: Frequent (HP:0040282). (ORPHA:36238)
- Chest pain (HP:0100749): An unpleasant sensation characterized by physical discomfort (such as pricking, throbbing, or aching) localized to the chest. Evidence: TAS. Frequency: Frequent (HP:0040282). (ORPHA:36238)
- Lethargy (HP:0001254): A state of fatigue, either physical or mental slowness and sluggishness, with difficulties in initiating or performing simple tasks. Distinguished from apathy which implies indifference and a lack of desire or interest in the task. A person with lethargy may have the desire, but not the energy to engage in personal or socially relevant tasks. Evidence: TAS. Frequency: Occasional (HP:0040283). (ORPHA:36238)
- Confusion (HP:0001289): Lack of clarity and coherence of thought, perception, understanding, or action. Evidence: TAS. Frequency: Occasional (HP:0040283). (ORPHA:36238)
- Decreased total leukocyte count (HP:0001882): An abnormal decreased number of leukocytes in the blood. Evidence: TAS. Frequency: Occasional (HP:0040283). (ORPHA:36238)
- Hemoptysis (HP:0002105): Coughing up (expectoration) of blood or blood-streaked sputum from the larynx, trachea, bronchi, or lungs. Evidence: TAS. Frequency: Occasional (HP:0040283). (ORPHA:36238)
- Pneumothorax (HP:0002107): Accumulation of air in the pleural cavity leading to a partially or completely collapsed lung. Evidence: TAS. Frequency: Occasional (HP:0040283). (ORPHA:36238)
- Pulmonary infiltrates (HP:0002113). Evidence: TAS. Frequency: Occasional (HP:0040283). (ORPHA:36238)
- Immunodeficiency (HP:0002721): Failure of the immune system to protect the body adequately from infection, due to the absence or insufficiency of some component process or substance. Evidence: TAS. Frequency: Occasional (HP:0040283). (ORPHA:36238)
- Shivering (HP:0025144): Involuntary contraction or twitching of the muscles. Evidence: TAS. Frequency: Occasional (HP:0040283). (ORPHA:36238)
- Pulmonary pneumatocele (HP:0025419): A pneumatocele is a thin walled, gas-filled space in the lung. It is most frequently caused by acute pneumonia, trauma, or aspiration of hydrocarbon fluid and is usually transient. The mechanism is believed to be a combination of parenchymal necrosis and check-valve airway obstruction. A pneumatocele appears as an approximately round, thin-walled airspace in the lung. Evidence: TAS. Frequency: Occasional (HP:0040283). (ORPHA:36238)
- Pharyngitis (HP:0025439): Inflammation (due to infection or irritation) of the pharynx. Evidence: TAS. Frequency: Occasional (HP:0040283). (ORPHA:36238)
- Shock (HP:0031273): The state in which profound and widespread reduction of effective tissue perfusion leads first to reversible, and then if prolonged, to irreversible cellular injury. Evidence: TAS. Frequency: Occasional (HP:0040283). (ORPHA:36238)
- Abnormal sputum (HP:0032016): Abnormal appearance of material expectorated (coughed up) from the respiratory system and that is composed of mucus but may contain other substances such as pus, blood, microorganisms, and fibrin. Evidence: TAS. Frequency: Occasional (HP:0040283). (ORPHA:36238)
- Gangrene (HP:0100758): A serious and potentially life-threatening condition that arises when a considerable mass of body tissue dies (necrosis). Evidence: TAS. Frequency: Occasional (HP:0040283). (ORPHA:36238)
- Sepsis (HP:0100806): Sepsis is defined as life-threatening organ dysfunction caused by a dysregulated host response to infection. Evidence: TAS. Frequency: Occasional (HP:0040283). (ORPHA:36238)
- Diabetes mellitus (HP:0000819): A group of abnormalities characterized by hyperglycemia and glucose intolerance. Evidence: TAS. Frequency: Very rare (HP:0040284). (ORPHA:36238)
- Addictive alcohol use (HP:0030955): An addictive behavior is defined as drinking excessive amounts of alcohol over a prolonged period of time, having difficulty in reducing the amount of alcohol consumed, strongly desiring alcohol, and experiencing withdrawal symptoms when not drinking alcohol. Evidence: TAS. Frequency: Very rare (HP:0040284). (ORPHA:36238)
- Fever (HP:0001945): Body temperature elevated above the normal range. Evidence: TAS. Frequency: Very frequent (HP:0040281). (ORPHA:36238)
- Increased total leukocyte count (HP:0001974): An abnormal increase in the number of leukocytes in the blood. Evidence: TAS. Frequency: Very frequent (HP:0040281). (ORPHA:36238)
- Pneumonia (HP:0002090): Inflammation of any part of the lung parenchyma. Evidence: TAS. Frequency: Very frequent (HP:0040281). (ORPHA:36238)
- Dyspnea (HP:0002094): Difficult or labored breathing. Dyspnea is a subjective feeling only the patient can rate, e.g., on a Borg scale. Evidence: TAS. Frequency: Very frequent (HP:0040281). (ORPHA:36238)
- Respiratory distress (HP:0002098): Respiratory distress is objectively observable as the physical or emotional consequences from the experience of dyspnea. The physical presentation of respiratory distress is generally referred to as labored breathing, while the sensation of respiratory distress is called shortness of breath or dyspnea. Evidence: TAS. Frequency: Very frequent (HP:0040281). (ORPHA:36238)
- Tachypnea (HP:0002789): Very rapid breathing. Evidence: TAS. Frequency: Very frequent (HP:0040281). (ORPHA:36238)
- Elevated erythrocyte sedimentation rate (HP:0003565): An increased erythrocyte sedimentation rate (ESR). The ESR is a test that measures the distance that erythrocytes have fallen after one hour in a vertical column of anticoagulated blood under the influence of gravity. The ESR is a nonspecific finding. An elevation may indicate inflammation or may be caused by any condition that elevates fibrinogen. Evidence: TAS. Frequency: Very frequent (HP:0040281). (ORPHA:36238)
- Cough (HP:0012735): A sudden, audible expulsion of air from the lungs through a partially closed glottis, preceded by inhalation. Evidence: TAS. Frequency: Very frequent (HP:0040281). (ORPHA:36238)
- Severe infection (HP:0032169): A type of infection that is regarded as a sign of a pathological susceptibility to infection because of unusual severity or intensity of the infection. Evidence: TAS. Frequency: Very frequent (HP:0040281). (ORPHA:36238)
- Pleural effusion (HP:0002202): The presence of an excessive amount of fluid in the pleural cavity. Evidence: TAS. Frequency: Frequent (HP:0040282). (ORPHA:36238)
- Hypotension (HP:0002615): Low Blood Pressure, vascular hypotension. Evidence: TAS. Frequency: Frequent (HP:0040282). (ORPHA:36238)
- Respiratory failure (HP:0002878): A severe form of respiratory insufficiency characterized by inadequate gas exchange such that the levels of oxygen or carbon dioxide cannot be maintained within normal limits. Evidence: TAS. Frequency: Frequent (HP:0040282). (ORPHA:36238)
- Elevated circulating C-reactive protein concentration (HP:0011227): The concentration of C-reactive protein in the blood circulation is above the upper limit of normal. Evidence: TAS. Frequency: Frequent (HP:0040282). (ORPHA:36238)
- Increased total neutrophil count (HP:0011897): Abnormal increase of absolute number of neutrophils in the blood, per microliter, compared to a reference range for a given sex and age-group. Evidence: TAS. Frequency: Frequent (HP:0040282). (ORPHA:36238)
- Pleural empyema (HP:0011919): Accumulation of pus in the pleural cavity. Evidence: TAS. Frequency: Frequent (HP:0040282). (ORPHA:36238)
- Acute infectious pneumonia (HP:0011949): Acute inflammation of the lung due to an infection. Evidence: TAS. Frequency: Frequent (HP:0040282). (ORPHA:36238)
These phenotypes are associated with the disease Staphylococcal necrotizing pneumonia (ORPHA:36238).